- Abnormal pinna morphology (HP:0000377): An abnormality of the pinna, which is also referred to as the auricle or external ear. Evidence: TAS. Frequency: Frequent (HP:0040282). (ORPHA:1305)
- Microcephaly (HP:0000252): Head circumference below 2 standard deviations below the mean for age and gender. Evidence: TAS. Frequency: Very frequent (HP:0040281). (ORPHA:1305)
- Brachydactyly (HP:0001156): Digits that appear disproportionately short compared to the hand/foot. The word brachydactyly is used here to describe a series distinct patterns of shortened digits (brachydactyly types A-E). This is the sense used here. Evidence: TAS. Frequency: Very frequent (HP:0040281). (ORPHA:1305)
- Clinodactyly of the 5th finger (HP:0004209): Clinodactyly refers to a bending or curvature of the fifth finger in the radial direction (i.e., towards the 4th finger). Evidence: TAS. Frequency: Very frequent (HP:0040281). (ORPHA:1305)
- Deviation of the 2nd finger (HP:0009468): Displacement of the 2nd finger from its normal position. Evidence: TAS. Frequency: Very frequent (HP:0040281). (ORPHA:1305)
- Short palpebral fissure (HP:0012745): Distance between the medial and lateral canthi is more than 2 SD below the mean for age (objective); or, apparently reduced length of the palpebral fissures. Evidence: TAS. Frequency: Very frequent (HP:0040281). (ORPHA:1305)
- Micrognathia (HP:0000347): Developmental hypoplasia of the mandible. Evidence: TAS. Frequency: Frequent (HP:0040282). (ORPHA:1305)
- Anteverted nares (HP:0000463): Anteriorly-facing nostrils viewed with the head in the Frankfurt horizontal and the eyes of the observer level with the eyes of the subject. This gives the appearance of an upturned nose (upturned nasal tip). Evidence: TAS. Frequency: Frequent (HP:0040282). (ORPHA:1305)
- Intellectual disability (HP:0001249): The term intellectual disability or intellectual developmental disorder is used to describe significantly sub-average intellectual and adaptive functioning based on clinical assessment and as measured by individually administered, appropriately normed, standardized and validated tests of intellectual functioning and adaptive behavior, with onset during the developmental period from infancy through adolescence. Evidence: TAS. Frequency: Frequent (HP:0040282). (ORPHA:1305)
- Toe syndactyly (HP:0001770): Webbing or fusion of the toes, involving soft parts only or including bone structure. Bony fusions are referred to as "bony" Syndactyly if the fusion occurs in a radio-ulnar axis. Fusions of bones of the toes in a proximo-distal axis are referred to as "Symphalangism". Evidence: TAS. Frequency: Frequent (HP:0040282). (ORPHA:1305)
- Hallux valgus (HP:0001822): Lateral deviation of the great toe (i.e., in the direction of the little toe). Evidence: TAS. Frequency: Frequent (HP:0040282). (ORPHA:1305)
- Short stature (HP:0004322): A height below that which is expected according to age and gender norms. Although there is no universally accepted definition of short stature, many refer to "short stature" as height more than 2 standard deviations below the mean for age and gender (or below the 3rd percentile for age and gender dependent norms). Evidence: TAS. Frequency: Frequent (HP:0040282). (ORPHA:1305)
- Depressed nasal bridge (HP:0005280): Posterior positioning of the nasal root in relation to the overall facial profile for age. Evidence: TAS. Frequency: Frequent (HP:0040282). (ORPHA:1305)
- Orofacial cleft (HP:0000202): The presence of a cleft (gap, opening, or groove) in the oral cavity, including cleft of the upper lip and/or cleft of the palate. Cleft of the upper lip is visible as a groove or fissure in the lip, most frequently due to a congenital failure of the maxillary and median nasal processes to fuse. Cleft palate is characterized by a grooved depression or fissure in the roof of the mouth, most often resulting from a congenital failure of the palate to fuse properly. Clefts of the lip and palate can occur individually or together. It is preferable to code each defect separately. Evidence: TAS. Frequency: Occasional (HP:0040283). (ORPHA:1305)
- Sensorineural hearing impairment (HP:0000407): A type of hearing impairment in one or both ears related to an abnormal functionality of the cochlear nerve. Evidence: TAS. Frequency: Occasional (HP:0040283). (ORPHA:1305)
- Patent ductus arteriosus (HP:0001643): In utero, the ductus arteriosus (DA) serves to divert ventricular output away from the lungs and toward the placenta by connecting the main pulmonary artery to the descending aorta. A patent ductus arteriosus (PDA) in the first 3 days of life is a physiologic shunt in healthy term and preterm newborn infants, and normally is substantially closed within about 24 hours after bith and completely closed after about three weeks. Failure of physiologcal closure is referred to a persistent or patent ductus arteriosus (PDA). Depending on the degree of left-to-right shunting, PDA can have clinical consequences. Evidence: TAS. Frequency: Occasional (HP:0040283). (ORPHA:1305)
- Annular pancreas (HP:0001734): A congenital anomaly in which the pancreas completely (or sometimes incompletely) encircles the second portion of duodenum and occasionally obstructs the more proximal duodenum. Evidence: TAS. Frequency: Occasional (HP:0040283). (ORPHA:1305)
- Abnormality of the spleen (HP:0001743): An abnormality of the spleen. Evidence: TAS. Frequency: Occasional (HP:0040283). (ORPHA:1305)
- Esophageal atresia (HP:0002032): A developmental defect resulting in complete obliteration of the lumen of the esophagus such that the esophagus ends in a blind pouch rather than connecting to the stomach. Evidence: TAS. Frequency: Occasional (HP:0040283). (ORPHA:1305)
- Duodenal atresia (HP:0002247): A developmental defect resulting in complete obliteration of the duodenal lumen, that is, an abnormal closure of the duodenum. Evidence: TAS. Frequency: Occasional (HP:0040283). (ORPHA:1305)
- Abnormal vertebral body morphology (HP:0003312): Abnormal form of vertebral body, which is the central cylindrical portion of the vertebra that together with other structures such as the vertebral arch, pedicles, laminae, spinous process, transverse processes, and articular facets makes up a vertebra. Evidence: TAS. Frequency: Occasional (HP:0040283). (ORPHA:1305)
These phenotypes are associated with the disease Feingold syndrome (ORPHA:1305).